- Autosomal dominant inheritance (HP:0000006): A mode of inheritance that is observed for traits related to a gene encoded on one of the autosomes (i.e., the human chromosomes 1-22) in which a trait manifests in heterozygotes. In the context of medical genetics, an autosomal dominant disorder is caused when a single copy of the mutant allele is present. Males and females are affected equally, and can both transmit the disorder with a risk of 50% for each child of inheriting the mutant allele. Evidence: TAS. (OMIM:107640)
- Sleep apnea (HP:0010535): An intermittent cessation of airflow at the mouth and nose during sleep is known as sleep apnea. Apneas that last at least 10 seconds are considered significant, but individuals with sleep apnea may experience apneas lasting from 20 seconds up to 2 or 3 minutes. Patients may have up to 15 events per hour of sleep. Evidence: TAS. (OMIM:107640)
- Sudden death (HP:0001699): Rapid and unexpected death. Evidence: TAS. (OMIM:107640)
These phenotypes are associated with the disease Apnea, central sleep (OMIM:107640).